Phenotypes associated with the disease migraine, familial typical, susceptibility to, 2 (OMIM:300125):
- Vomiting (HP:0002013): Forceful ejection of the contents of the stomach through the mouth by means of a series of involuntary spasmic contractions. Evidence: IEA. (OMIM:300125)
- Migraine with aura (HP:0002077): A type of migraine in which there is an aura characterized by focal neurological phenomena that usually proceed, but may accompany or occur in the absence of, the headache. The symptoms of an aura may include fully reversible visual, sensory, and speech symptoms but not motor weakness. Visual symptoms may include flickering lights, spots and lines and/or loss of vision and/or unilateral sensory symptoms such as paresthesias or numbness. At least one of the symptoms of an aura develops gradually over 5 or more minutes and/or different symptoms occur in succession. Evidence: IEA. (OMIM:300125)
- Photophobia (HP:0000613): Excessive sensitivity to light with the sensation of discomfort or pain in the eyes due to exposure to bright light. Evidence: IEA. (OMIM:300125)
- Migraine without aura (HP:0002083): Repeated headache attacks lasting 4-72 h fulfilling at least two of the following criteria: 1) unilateral location, 2) pulsating quality, 3) moderate or severe pain intensity, and 4) aggravation by or causing avoidance of routine physical activity such as climbing stairs. Headache attacks are commonly accompanied by nausea, vomiting, photophobia, or phonophobia. Evidence: IEA. (OMIM:300125)
- Phonophobia (HP:0002183): An abnormally heightened sensitivity to loud sounds. Evidence: IEA. (OMIM:300125)
- X-linked inheritance (HP:0001417): A mode of inheritance that is observed for traits related to a gene encoded on the X chromosome. Evidence: IEA. (OMIM:300125)
- Nausea (HP:0002018): A sensation of unease in the stomach together with an urge to vomit. Evidence: IEA. (OMIM:300125)